- Bilateral tonic-clonic seizure (HP:0002069): A bilateral tonic-clonic seizure is a seizure defined by a tonic (bilateral increased tone, lasting seconds to minutes) and then a clonic (bilateral sustained rhythmic jerking) phase. Evidence: IEA. (OMIM:600176)
- Atypical absence seizure (HP:0007270): An atypical absence seizure is a type of generalized non-motor (absence) seizure characterized by interruption of ongoing activities and reduced responsiveness. In comparison to a typical absence seizure, changes in tone may be more pronounced, onset and/or cessation may be less abrupt, and the duration of the ictus and post-ictal recovery may be longer. Although not always available, an EEG often demonstrates slow (<3 Hz), irregular, generalized spike-wave activity. Evidence: IEA. (OMIM:600176)
- Abnormality of the skeletal system (HP:0000924): An abnormality of the skeletal system. Evidence: IEA. (OMIM:600176)
- Global developmental delay (HP:0001263): A delay in the achievement of motor or mental milestones in the domains of development of a child, including motor skills, speech and language, cognitive skills, and social and emotional skills. This term should only be used to describe children younger than five years of age. Evidence: TAS. (OMIM:600176)
- Arachnoid cyst (HP:0100702): An extra-parenchymal and intra-arachnoidal collection of fluid with a composition similar to that of cerebrospinal fluid. Evidence: TAS. (OMIM:600176)
- Autosomal recessive inheritance (HP:0000007): A mode of inheritance that is observed for traits related to a gene encoded on one of the autosomes (i.e., the human chromosomes 1-22) in which a trait manifests in individuals with two pathogenic alleles, either homozygotes (two copies of the same mutant allele) or compound heterozygotes (whereby each copy of a gene has a distinct mutant allele). Evidence: IEA. (OMIM:600176)
- Profound static encephalopathy (HP:0007069). Evidence: IEA. (OMIM:600176)
- Pachygyria (HP:0001302): Pachygyria is a malformation of cortical development with abnormally wide gyri with sulci 1,5-3 cm apart and abnormally thick cortex measuring more than 5 mm (radiological definition). See also neuropathological definitions for 2-, 3-, and 4-layered lissencephaly. Evidence: TAS. (OMIM:600176)
- Intellectual disability (HP:0001249): The term intellectual disability or intellectual developmental disorder is used to describe significantly sub-average intellectual and adaptive functioning based on clinical assessment and as measured by individually administered, appropriately normed, standardized and validated tests of intellectual functioning and adaptive behavior, with onset during the developmental period from infancy through adolescence. Evidence: IEA. (OMIM:600176)
These phenotypes are associated with the disease pachygyria-intellectual disability-epilepsy syndrome (OMIM:600176).